- High maternal circulating chorionic gonadotropin concentration (HP:0011433): An abnormally high concentration of maternal serum human chorionic gonadotropin as compared to normal values for gestational-age. Evidence: TAS. Frequency: Very frequent (HP:0040281). (ORPHA:99925)
- Menometrorrhagia (HP:0400008): Prolonged/excessive menses and bleeding at irregular intervals. Evidence: TAS. Frequency: Very frequent (HP:0040281). (ORPHA:99925)
These phenotypes are associated with the disease Invasive mole (ORPHA:99925).